- Dysphagia (HP:0002015): Difficulty in swallowing. Evidence: IEA. (OMIM:603511)
- Elevated circulating creatine kinase activity (HP:0003236): The activity of creatine kinase in the blood circulation is above the upper limit of normal. Evidence: IEA. (OMIM:603511)
- Facial palsy (HP:0010628): Facial nerve palsy is a dysfunction of cranial nerve VII (the facial nerve) that results in inability to control facial muscles on the affected side with weakness of the muscles of facial expression and eye closure. This can either be present in unilateral or bilateral form. Evidence: TAS. Frequency: Occasional (HP:0040283). (OMIM:603511)
- Muscle fiber splitting (HP:0003555): Fiber splitting or branching is a common finding in human and rat skeletal muscle pathology. Fiber splitting refers to longitudinal halving of the complete fiber, while branching originates from a regenerating end of a necrotic fiber as invaginations of the sarcolemma. In fiber branching, one end of the fiber remains intact as a single entity, while the other end has several branches. Evidence: TAS. (OMIM:603511)
- Bulbar palsy (HP:0001283): Bulbar weakness (or bulbar palsy) refers to bilateral impairment of function of the lower cranial nerves IX, X, XI and XII, which occurs due to lower motor neuron lesion either at nuclear or fascicular level in the medulla or from bilateral lesions of the lower cranial nerves outside the brain-stem. Bulbar weakness is often associated with difficulty in chewing, weakness of the facial muscles, dysarthria, palatal weakness and regurgitation of fluids, dysphagia, and dysphonia. Evidence: TAS. Frequency: Occasional (HP:0040283). (OMIM:603511)
- Flexion contracture (HP:0001371): A flexion contracture is a bent (flexed) joint that cannot be straightened actively or passively. It is thus a chronic loss of joint motion due to structural changes in muscle, tendons, ligaments, or skin that prevents normal movement of joints. Evidence: TAS. Frequency: Occasional (HP:0040283). (OMIM:603511)
- Difficulty climbing stairs (HP:0003551): Reduced ability to climb stairs. Evidence: PCS. Frequency: 6/9. (PMID:22334415)
- Muscular dystrophy (HP:0003560): The term dystrophy means abnormal growth. However, muscular dystrophy is used to describe primary myopathies with a genetic basis and a progressive course characterized by progressive skeletal muscle weakness and wasting, defects in muscle proteins, and histological features of muscle fiber degeneration (necrosis) and regeneration. If possible, it is preferred to use other HPO terms to describe the precise phenotypic abnormalities. Evidence: PCS. (PMID:22334415)
- Dyspnea (HP:0002094): Difficult or labored breathing. Dyspnea is a subjective feeling only the patient can rate, e.g., on a Borg scale. Evidence: TAS. Frequency: Occasional (HP:0040283). (OMIM:603511)
- Gowers sign (HP:0003391): A phenomenon whereby patients are not able to stand up without the use of the hands owing to weakness of the proximal muscles of the lower limbs. Evidence: PCS. Frequency: 2/9. (PMID:22334415)
- Decreased compound muscle action potential amplitude (HP:0033383): Reduced level of the compound muscle action potential (CMAP), which is recorded following electrical stimulation of a nerve from surface electrodes overlying a muscle supplied by that nerve. Evidence: PCS. Frequency: 2/2. (PMID:22334415)
- Young adult onset (HP:0011462): Onset of disease at the age of between 16 and 40 years. Evidence: PCS. Frequency: 9/9. (PMID:22334415)
- Difficulty running (HP:0009046): Reduced ability to run. Evidence: PCS. Frequency: 1/9. (PMID:22334415)
- Pelvic girdle muscle weakness (HP:0003749): Weakness of the muscles of the pelvic girdle (also known as the hip girdle), that is, lack of strength of the muscles around the pelvis. Evidence: PCS. (PMID:22334415)
- Rimmed vacuoles (HP:0003805): Presence of abnormal vacuoles (membrane-bound organelles) in the sarcolemma. On histological staining with hematoxylin and eosin, rimmed vacuoles are popcorn-like clear vacuoles with a densely blue rim. The vacuoles are often associated with cytoplasmic and occasionally intranuclear eosinophilic inclusions. Evidence: PCS. Frequency: 1/1. (PMID:22334415)
- Waddling gait (HP:0002515): Weakness of the hip girdle and upper thigh muscles, for instance in myopathies, leads to an instability of the pelvis on standing and walking. If the muscles extending the hip joint are affected, the posture in that joint becomes flexed and lumbar lordosis increases. The patients usually have difficulties standing up from a sitting position. Due to weakness in the gluteus medius muscle, the hip on the side of the swinging leg drops with each step (referred to as Trendelenburg sign). The gait appears waddling. The patients frequently attempt to counteract the dropping of the hip on the swinging side by bending the trunk towards the side which is in the stance phase (in the German language literature this is referred to as Duchenne sign). Similar gait patterns can be caused by orthopedic conditions when the origin and the insertion site of the gluteus medius muscle are closer to each other than normal, for instance due to a posttraumatic elevation of the trochanter or pseudarthrosis of the femoral neck. Evidence: PCS. Frequency: 4/9. (PMID:22334415)
- Loss of ambulation (HP:0002505): Inability to walk in a person who previous had the ability to walk. Evidence: PCS. Frequency: 5/9. (PMID:22334415)
- Shoulder girdle muscle weakness (HP:0003547): The shoulder, or pectoral, girdle is composed of the clavicles and the scapulae. Shoulder-girdle weakness refers to lack of strength of the muscles attaching to these bones, that is, lack of strength of the muscles around the shoulders. Evidence: PCS. (PMID:22334415)
- Autosomal dominant inheritance (HP:0000006): A mode of inheritance that is observed for traits related to a gene encoded on one of the autosomes (i.e., the human chromosomes 1-22) in which a trait manifests in heterozygotes. In the context of medical genetics, an autosomal dominant disorder is caused when a single copy of the mutant allele is present. Males and females are affected equally, and can both transmit the disorder with a risk of 50% for each child of inheriting the mutant allele. Evidence: PCS. (PMID:22334415)
- Slowly progressive (HP:0003677): Applies to a disease manifestation that only slowly increases in scope or severity over the course of time. Evidence: PCS. (PMID:22334415)
- Myalgia (HP:0003326): Pain in muscle. Evidence: PCS. Frequency: 1/9. (PMID:22334415)
These phenotypes are associated with the disease autosomal dominant limb-girdle muscular dystrophy type 1D (DNAJB6) (OMIM:603511).